- Thick lower lip vermilion (HP:0000179): Increased thickness of the lower lip, leading to a prominent appearance of the lower lip. The height of the vermilion of the lower lip in the midline is more than 2 SD above the mean. Alternatively, an apparently increased height of the vermilion of the lower lip in the frontal view (subjective). Evidence: TAS. Frequency: Occasional (HP:0040283). (ORPHA:2057)
- Mandibular prognathia (HP:0000303): Abnormal prominence of the chin related to increased length of the mandible. Evidence: TAS. Frequency: Very frequent (HP:0040281). (ORPHA:2057)
- Hypertelorism (HP:0000316): Interpupillary distance more than 2 SD above the mean (alternatively, the appearance of an increased interpupillary distance or widely spaced eyes). Evidence: TAS. Frequency: Occasional (HP:0040283). (ORPHA:2057)
- Anosmia (HP:0000458): An inability to perceive odors. This is a general term describing inability to smell arising in any part of the process of smelling from absorption of odorants into the nasal mucous overlying the olfactory epithelium, diffusion to the cilia, binding to olfactory receptor sites, generation of action potentials in olfactory neurons, and perception of a smell. Evidence: TAS. Frequency: Occasional (HP:0040283). (ORPHA:2057)
- Ptosis (HP:0000508): The upper eyelid margin is positioned 3 mm or more lower than usual and covers the superior portion of the iris (objective); or, the upper lid margin obscures at least part of the pupil (subjective). Evidence: TAS. Frequency: Very frequent (HP:0040281). (ORPHA:2057)
- Esotropia (HP:0000565): A form of strabismus with one or both eyes turned inward ('crossed') to a relatively severe degree, usually defined as 10 diopters or more. Evidence: TAS. Frequency: Very frequent (HP:0040281). (ORPHA:2057)
- Thick eyebrow (HP:0000574): Increased density/number and/or increased diameter of eyebrow hairs. Evidence: TAS. Frequency: Very frequent (HP:0040281). (ORPHA:2057)
- Blepharophimosis (HP:0000581): A fixed reduction in the vertical distance between the upper and lower eyelids with short palpebral fissures. Evidence: TAS. Frequency: Very frequent (HP:0040281). (ORPHA:2057)
- Synophrys (HP:0000664): Meeting of the medial eyebrows in the midline. Evidence: TAS. Frequency: Very frequent (HP:0040281). (ORPHA:2057)
- Abnormal cranial nerve morphology (HP:0001291): Structural abnormality affecting one or more of the cranial nerves, which emerge directly from the brain stem. Evidence: TAS. Frequency: Very frequent (HP:0040281). (ORPHA:2057)
- Highly arched eyebrow (HP:0002553): Increased height of the central portion of the eyebrow, forming a crescent, semicircular, or inverted U shape. Evidence: TAS. Frequency: Very frequent (HP:0040281). (ORPHA:2057)
- Short stature (HP:0004322): A height below that which is expected according to age and gender norms. Although there is no universally accepted definition of short stature, many refer to "short stature" as height more than 2 standard deviations below the mean for age and gender (or below the 3rd percentile for age and gender dependent norms). Evidence: TAS. Frequency: Frequent (HP:0040282). (ORPHA:2057)
- Borderline intellectual disability (HP:0006889): Borderline intellectual disability is defined as an intelligence quotient (IQ) in the range of 70-85. Evidence: TAS. Frequency: Occasional (HP:0040283). (ORPHA:2057)
These phenotypes are associated with the disease Blepharophimosis-ptosis-esotropia-syndactyly-short stature syndrome (ORPHA:2057).